- Impacted cerumen (HP:0030788): Blockage of the external auditory canal by a buildup of earwax. Evidence: PCS. (PMID:25459316)
- Exostoses (HP:0100777): An exostosis is a benign growth the projects outward from the bone surface. It is capped by cartilage, and arises from a bone that develops from cartilage. Evidence: PCS. (PMID:25459316)
- Hearing impairment (HP:0000365): A decreased magnitude of the sensory perception of sound. Evidence: PCS. (PMID:25459316)
- Autosomal dominant inheritance (HP:0000006): A mode of inheritance that is observed for traits related to a gene encoded on one of the autosomes (i.e., the human chromosomes 1-22) in which a trait manifests in heterozygotes. In the context of medical genetics, an autosomal dominant disorder is caused when a single copy of the mutant allele is present. Males and females are affected equally, and can both transmit the disorder with a risk of 50% for each child of inheriting the mutant allele. Evidence: IEA. (OMIM:128300)
- Exostosis of the external auditory canal (HP:0004459): A benign bony growth projecting outward from a bone surface within the external auditory canal. Evidence: IEA. (OMIM:128300)
- Otitis externa (HP:0410017): Inflammation or infection of the external auditory canal (EAC), the auricle, or both. Evidence: PCS. (PMID:25459316)
These phenotypes are associated with the disease ear exostoses (OMIM:128300).